Phenotypes associated with the disease Megalencephalic leukoencephalopathy with subcortical cysts (ORPHA:2478):
- Atypical behavior (HP:0000708): Atypical behavior is an abnormality in a person's actions that can be controlled or modulated by the will of the individual. While abnormal behaviors can be difficult to control, they are distinct from other abnormal actions that cannot be affected by the individual's will. Evidence: TAS. Frequency: Frequent (HP:0040282). (ORPHA:2478)
- Seizure (HP:0001250): A seizure is an intermittent abnormality of nervous system physiology characterized by a transient occurrence of signs and/or symptoms due to abnormal excessive or synchronous neuronal activity in the brain. Evidence: TAS. Frequency: Frequent (HP:0040282). (ORPHA:2478)
- Ataxia (HP:0001251): Ataxia refers to impaired coordination of voluntary muscle movement. Cerebellar ataxia refers to ataxia due to dysfunction of the cerebellum. This causes a variety of elementary neurological deficits including asynergy (lack of coordination between muscles, limbs and joints), dysmetria (lack of ability to judge distances that can lead to under- or overshoot in grasping movements), and dysdiadochokinesia (inability to perform rapid movements requiring antagonizing muscle groups to be switched on and off repeatedly). Evidence: TAS. Frequency: Frequent (HP:0040282). (ORPHA:2478)
- Spasticity (HP:0001257): A motor disorder characterized by a velocity-dependent increase in tonic stretch reflexes with increased muscle tone, exaggerated (hyperexcitable) tendon reflexes. Evidence: TAS. Frequency: Frequent (HP:0040282). (ORPHA:2478)
- Mental deterioration (HP:0001268): Loss of previously present mental abilities, generally in adults. Evidence: TAS. Frequency: Frequent (HP:0040282). (ORPHA:2478)
- Unsteady gait (HP:0002317). Evidence: TAS. Frequency: Frequent (HP:0040282). (ORPHA:2478)
- Motor deterioration (HP:0002333): Loss of previously present motor (i.e., movement) abilities. Evidence: TAS. Frequency: Frequent (HP:0040282). (ORPHA:2478)
- Postnatal macrocephaly (HP:0005490): The postnatal development of an abnormally large skull (macrocephaly). Evidence: TAS. Frequency: Frequent (HP:0040282). (ORPHA:2478)
- Diffuse swelling of cerebral white matter (HP:0007341). Evidence: TAS. Frequency: Frequent (HP:0040282). (ORPHA:2478)
- Cerebral subcortical cyst (HP:6000461): A fluid-filled sac (cyst) in the region below the cortex of the cerebrum. In magnetic resonance imaging, the fluid within the cyst has the same appearance as cerebrospinal fluid (CSF). Evidence: TAS. Frequency: Frequent (HP:0040282). (ORPHA:2478)
- Autism (HP:0000717): Autism is a neurodevelopmental disorder characterized by impaired social interaction and communication, and by restricted and repetitive behavior. Autism begins in childhood. It is marked by the presence of markedly abnormal or impaired development in social interaction and communication and a markedly restricted repertoire of activity and interest. Manifestations of the disorder vary greatly depending on the developmental level and chronological age of the individual (DSM-IV). Evidence: TAS. Frequency: Occasional (HP:0040283). (ORPHA:2478)
- Intellectual disability (HP:0001249): The term intellectual disability or intellectual developmental disorder is used to describe significantly sub-average intellectual and adaptive functioning based on clinical assessment and as measured by individually administered, appropriately normed, standardized and validated tests of intellectual functioning and adaptive behavior, with onset during the developmental period from infancy through adolescence. Evidence: TAS. Frequency: Occasional (HP:0040283). (ORPHA:2478)
- Dystonia (HP:0001332): An abnormally increased muscular tone that causes fixed abnormal postures. There is a slow, intermittent twisting motion that leads to exaggerated turning and posture of the extremities and trunk. Evidence: TAS. Frequency: Occasional (HP:0040283). (ORPHA:2478)
- Abnormality of extrapyramidal motor function (HP:0002071): A neurological condition related to lesions of the basal ganglia leading to typical abnormalities including akinesia (inability to initiate changes in activity and perform volitional movements rapidly and easily), muscular rigidity (continuous contraction of muscles with constant resistance to passive movement), chorea (widespread arrhythmic movements of a forcible, rapid, jerky, and restless nature), athetosis (inability to sustain the muscles of the fingers, toes, or other group of muscles in a fixed position), and akathisia (inability to remain motionless). Evidence: TAS. Frequency: Occasional (HP:0040283). (ORPHA:2478)
- Status epilepticus (HP:0002133): Status epilepticus is a type of prolonged seizure resulting either from the failure of the mechanisms responsible for seizure termination or from the initiation of mechanisms which lead to abnormally prolonged seizures (after time point t1). It is a condition that can have long-term consequences (after time point t2), including neuronal death, neuronal injury, and alteration of neuronal networks, depending on the type and duration of seizures. Evidence: TAS. Frequency: Occasional (HP:0040283). (ORPHA:2478)
- Athetosis (HP:0002305): A slow, continuous, involuntary writhing movement that prevents maintenance of a stable posture. Athetosis involves continuous smooth movements that appear random and are not composed of recognizable sub-movements or movement fragments. In contrast to chorea, in athetosis, the same regions of the body are repeatedly involved. Athetosis may worsen with attempts at movement of posture, but athetosis can also occur at rest. Evidence: TAS. Frequency: Occasional (HP:0040283). (ORPHA:2478)
- Clumsiness (HP:0002312): Lack of physical coordination resulting in an abnormal tendency to drop items or bump into objects. Evidence: TAS. Frequency: Occasional (HP:0040283). (ORPHA:2478)
- Cerebral white matter atrophy (HP:0012762): The presence of atrophy (wasting) of the cerebral white matter. Evidence: TAS. Frequency: Occasional (HP:0040283). (ORPHA:2478)